- Posteriorly rotated ears (HP:0000358): A type of abnormal location of the ears in which the position of the ears is characterized by posterior rotation (the superior part of the ears is rotated towards the back of the head, and the inferior part of the ears towards the front). Evidence: TAS. Frequency: Very frequent (HP:0040281). (ORPHA:1308)
- Cryptorchidism (HP:0000028): Testis in inguinal canal. That is, absence of one or both testes from the scrotum owing to failure of the testis or testes to descend through the inguinal canal to the scrotum. Evidence: TAS. Frequency: Very frequent (HP:0040281). (ORPHA:1308)
- Gingival overgrowth (HP:0000212): Hyperplasia of the gingiva (that is, a thickening of the soft tissue overlying the alveolar ridge. The degree of thickening ranges from involvement of the interdental papillae alone to gingival overgrowth covering the entire tooth crown. Evidence: TAS. Frequency: Very frequent (HP:0040281). (ORPHA:1308)
- High palate (HP:0000218): Height of the palate more than 2 SD above the mean (objective) or palatal height at the level of the first permanent molar more than twice the height of the teeth (subjective). Evidence: TAS. Frequency: Very frequent (HP:0040281). (ORPHA:1308)
- Trigonocephaly (HP:0000243): Wedge-shaped, or triangular head, with the apex of the triangle at the midline of the forehead and the base of the triangle at the occiput. Evidence: TAS. Frequency: Very frequent (HP:0040281). (ORPHA:1308)
- Microcephaly (HP:0000252): Head circumference below 2 standard deviations below the mean for age and gender. Evidence: TAS. Frequency: Very frequent (HP:0040281). (ORPHA:1308)
- Epicanthus (HP:0000286): A fold of skin starting above the medial aspect of the upper eyelid and arching downward to cover, pass in front of and lateral to the medial canthus. Evidence: TAS. Frequency: Very frequent (HP:0040281). (ORPHA:1308)
- Smooth philtrum (HP:0000319): Flat skin surface, with no ridge formation in the central region of the upper lip between the nasal base and upper vermilion border. Evidence: TAS. Frequency: Very frequent (HP:0040281). (ORPHA:1308)
- Long philtrum (HP:0000343): Distance between nasal base and midline upper lip vermilion border more than 2 SD above the mean. Alternatively, an apparently increased distance between nasal base and midline upper lip vermilion border. Evidence: TAS. Frequency: Very frequent (HP:0040281). (ORPHA:1308)
- Micrognathia (HP:0000347): Developmental hypoplasia of the mandible. Evidence: TAS. Frequency: Very frequent (HP:0040281). (ORPHA:1308)
- Anteverted nares (HP:0000463): Anteriorly-facing nostrils viewed with the head in the Frankfurt horizontal and the eyes of the observer level with the eyes of the subject. This gives the appearance of an upturned nose (upturned nasal tip). Evidence: TAS. Frequency: Very frequent (HP:0040281). (ORPHA:1308)
- Short neck (HP:0000470): Diminished length of the neck. Evidence: TAS. Frequency: Very frequent (HP:0040281). (ORPHA:1308)
- Upslanted palpebral fissure (HP:0000582): The palpebral fissure inclination is more than two standard deviations above the mean for age (objective); or, the inclination of the palpebral fissure is greater than typical for age. Evidence: TAS. Frequency: Very frequent (HP:0040281). (ORPHA:1308)
- Intellectual disability (HP:0001249): The term intellectual disability or intellectual developmental disorder is used to describe significantly sub-average intellectual and adaptive functioning based on clinical assessment and as measured by individually administered, appropriately normed, standardized and validated tests of intellectual functioning and adaptive behavior, with onset during the developmental period from infancy through adolescence. Evidence: TAS. Frequency: Very frequent (HP:0040281). (ORPHA:1308)
- Short nose (HP:0003196): Distance from nasion to subnasale more than two standard deviations below the mean, or alternatively, an apparently decreased length from the nasal root to the nasal tip. Evidence: TAS. Frequency: Very frequent (HP:0040281). (ORPHA:1308)
- Clinodactyly of the 5th finger (HP:0004209): Clinodactyly refers to a bending or curvature of the fifth finger in the radial direction (i.e., towards the 4th finger). Evidence: TAS. Frequency: Very frequent (HP:0040281). (ORPHA:1308)
- Biparietal narrowing (HP:0004422): A narrowing of the biparietal diameter (i.e., of the transverse distance between the protuberances of the two parietal bones of the skull). Evidence: TAS. Frequency: Very frequent (HP:0040281). (ORPHA:1308)
- Depressed nasal bridge (HP:0005280): Posterior positioning of the nasal root in relation to the overall facial profile for age. Evidence: TAS. Frequency: Very frequent (HP:0040281). (ORPHA:1308)
- Female pseudohermaphroditism (HP:0010458): Hermaphroditism refers to a discrepancy between the morphology of the gonads and that of the external genitalia. In female pseudohermaphroditism, the genotype is female (XX) and the gonads are ovaries, but the external genitalia are virilized. Evidence: TAS. Frequency: Very frequent (HP:0040281). (ORPHA:1308)
- Hypoplasia of the ear cartilage (HP:0100720). Evidence: TAS. Frequency: Very frequent (HP:0040281). (ORPHA:1308)
- Accessory oral frenulum (HP:0000191): Extra fold of tissue extending from the alveolar ridge to the inner surface of the upper or lower lip. Evidence: TAS. Frequency: Frequent (HP:0040282). (ORPHA:1308)
- Thin vermilion border (HP:0000233): Height of the vermilion of the medial part of the lip more than 2 SD below the mean, or apparently reduced height of the vermilion of the lip in the frontal view. The vermilion is the red part of the lips (and confusingly, the vermilion itself is also often referred to as being equivalent the lips). Evidence: TAS. Frequency: Frequent (HP:0040282). (ORPHA:1308)
- Strabismus (HP:0000486): A misalignment of the eyes so that the visual axes deviate from bifoveal fixation. The classification of strabismus may be based on a number of features including the relative position of the eyes, whether the deviation is latent or manifest, intermittent or constant, concomitant or otherwise and according to the age of onset and the relevance of any associated refractive error. Evidence: TAS. Frequency: Frequent (HP:0040282). (ORPHA:1308)
- Pectus excavatum (HP:0000767): A defect of the chest wall characterized by a depression of the sternum, giving the chest ("pectus") a caved-in ("excavatum") appearance. Evidence: TAS. Frequency: Frequent (HP:0040282). (ORPHA:1308)
- Sacral dimple (HP:0000960): A cutaneous indentation resulting from tethering of the skin to underlying structures (bone) of the intergluteal cleft. Evidence: TAS. Frequency: Frequent (HP:0040282). (ORPHA:1308)
- Seizure (HP:0001250): A seizure is an intermittent abnormality of nervous system physiology characterized by a transient occurrence of signs and/or symptoms due to abnormal excessive or synchronous neuronal activity in the brain. Evidence: TAS. Frequency: Frequent (HP:0040282). (ORPHA:1308)
- Hypotonia (HP:0001252): Hypotonia is an abnormally low muscle tone (the amount of tension or resistance to movement in a muscle). Even when relaxed, muscles have a continuous and passive partial contraction which provides some resistance to passive stretching. Hypotonia thus manifests as diminished resistance to passive stretching. Hypotonia is not the same as muscle weakness, although the two conditions can co-exist. Evidence: TAS. Frequency: Frequent (HP:0040282). (ORPHA:1308)
- Joint dislocation (HP:0001373): Displacement or malalignment of joints. Evidence: TAS. Frequency: Frequent (HP:0040282). (ORPHA:1308)
- Limitation of joint mobility (HP:0001376): A reduction in the freedom of movement of one or more joints. Evidence: TAS. Frequency: Frequent (HP:0040282). (ORPHA:1308)
- Failure to thrive in infancy (HP:0001531). Evidence: TAS. Frequency: Frequent (HP:0040282). (ORPHA:1308)
- Redundant skin (HP:0001582): Loose and sagging skin often associated with loss of skin elasticity. Evidence: TAS. Frequency: Frequent (HP:0040282). (ORPHA:1308)
- Talipes (HP:0001883): A deformity of foot and ankle that has different subtypes that are talipes equinovarus, talipes equinovalgus, talipes calcaneovarus and talipes calcaneovalgus. Evidence: TAS. Frequency: Frequent (HP:0040282). (ORPHA:1308)
- Micromelia (HP:0002983): The presence of abnormally small extremities. Evidence: TAS. Frequency: Frequent (HP:0040282). (ORPHA:1308)
- Dislocated radial head (HP:0003083): A dislocation of the head of the radius from its socket in the elbow joint. Evidence: TAS. Frequency: Frequent (HP:0040282). (ORPHA:1308)
- Short stature (HP:0004322): A height below that which is expected according to age and gender norms. Although there is no universally accepted definition of short stature, many refer to "short stature" as height more than 2 standard deviations below the mean for age and gender (or below the 3rd percentile for age and gender dependent norms). Evidence: TAS. Frequency: Frequent (HP:0040282). (ORPHA:1308)
- Abnormality of the anus (HP:0004378): Abnormality of the anal canal. Evidence: TAS. Frequency: Frequent (HP:0040282). (ORPHA:1308)
- Bilateral single transverse palmar creases (HP:0007598): The distal and proximal transverse palmar creases are merged into a single transverse palmar crease on both hands. Evidence: TAS. Frequency: Frequent (HP:0040282). (ORPHA:1308)
- Midline facial capillary hemangioma (HP:0007601). Evidence: TAS. Frequency: Frequent (HP:0040282). (ORPHA:1308)
- Abnormality of immune system physiology (HP:0010978): A functional abnormality of the immune system. Evidence: TAS. Frequency: Frequent (HP:0040282). (ORPHA:1308)
- Abnormal cardiovascular system morphology (HP:0030680): Any structural anomaly of the heart and blood vessels. Evidence: TAS. Frequency: Frequent (HP:0040282). (ORPHA:1308)
- Multicystic kidney dysplasia (HP:0000003): Multicystic dysplasia of the kidney is characterized by multiple cysts of varying size in the kidney and the absence of a normal pelvicaliceal system. The condition is associated with ureteral or ureteropelvic atresia, and the affected kidney is nonfunctional. Evidence: TAS. Frequency: Occasional (HP:0040283). (ORPHA:1308)
- Horseshoe kidney (HP:0000085): A connection of the right and left kidney by an isthmus of functioning renal parenchyma or fibrous tissue that crosses the midline. Evidence: TAS. Frequency: Occasional (HP:0040283). (ORPHA:1308)
- Cleft palate (HP:0000175): Cleft palate is a developmental defect of the palate resulting from a failure of fusion of the palatine processes and manifesting as a separation of the roof of the mouth (soft and hard palate). Evidence: TAS. Frequency: Occasional (HP:0040283). (ORPHA:1308)
- Congenital diaphragmatic hernia (HP:0000776): The presence of a hernia of the diaphragm present at birth. Evidence: TAS. Frequency: Occasional (HP:0040283). (ORPHA:1308)
- Hand polydactyly (HP:0001161): A kind of polydactyly characterized by the presence of a supernumerary finger or fingers. Evidence: TAS. Frequency: Occasional (HP:0040283). (ORPHA:1308)
- Death in infancy (HP:0001522): Death within the first 24 months of life. Evidence: TAS. Frequency: Occasional (HP:0040283). (ORPHA:1308)
- Omphalocele (HP:0001539): A midline anterior incomplete closure of the abdominal wall in which there is herniation of the abdominal viscera into the base of the abdominal cord. Evidence: TAS. Frequency: Occasional (HP:0040283). (ORPHA:1308)
- Polyhydramnios (HP:0001561): The presence of excess amniotic fluid in the uterus during pregnancy. Evidence: TAS. Frequency: Occasional (HP:0040283). (ORPHA:1308)
- Toe syndactyly (HP:0001770): Webbing or fusion of the toes, involving soft parts only or including bone structure. Bony fusions are referred to as "bony" Syndactyly if the fusion occurs in a radio-ulnar axis. Fusions of bones of the toes in a proximo-distal axis are referred to as "Symphalangism". Evidence: TAS. Frequency: Occasional (HP:0040283). (ORPHA:1308)
- Constipation (HP:0002019): Infrequent or difficult evacuation of feces. Evidence: TAS. Frequency: Occasional (HP:0040283). (ORPHA:1308)
- Aplasia/Hypoplasia of the corpus callosum (HP:0007370): Absence or underdevelopment of the corpus callosum. Evidence: TAS. Frequency: Occasional (HP:0040283). (ORPHA:1308)
- Renal hypoplasia/aplasia (HP:0008678): Absence or underdevelopment of the kidney. Evidence: TAS. Frequency: Occasional (HP:0040283). (ORPHA:1308)
- Aplasia/Hypoplasia of the abdominal wall musculature (HP:0010318): Absence or underdevelopment of the abdominal musculature. Evidence: TAS. Frequency: Occasional (HP:0040283). (ORPHA:1308)
- Abnormal hair pattern (HP:0010720): An abnormality of the distribution of hair growth. Evidence: TAS. Frequency: Occasional (HP:0040283). (ORPHA:1308)
These phenotypes are associated with the disease C syndrome (ORPHA:1308).